- Wide mouth (HP:0000154): Distance between the oral commissures more than 2 SD above the mean. Alternatively, an apparently increased width of the oral aperture (subjective). Evidence: TAS. Frequency: Very frequent (HP:0040281). (ORPHA:1517)
- Macrocephaly (HP:0000256): Occipitofrontal (head) circumference greater than 97th centile compared to appropriate, age matched, sex-matched normal standards. Alternatively, a apparently increased size of the cranium. Evidence: TAS. Frequency: Frequent (HP:0040282). (ORPHA:1517)
- Coarse facial features (HP:0000280): Absence of fine and sharp appearance of brows, nose, lips, mouth, and chin, usually because of rounded and heavy features or thickened skin with or without thickening of subcutaneous and bony tissues. Evidence: TAS. Frequency: Very frequent (HP:0040281). (ORPHA:1517)
- Epicanthus (HP:0000286): A fold of skin starting above the medial aspect of the upper eyelid and arching downward to cover, pass in front of and lateral to the medial canthus. Evidence: TAS. Frequency: Frequent (HP:0040282). (ORPHA:1517)
- Low anterior hairline (HP:0000294): Distance between the hairline (trichion) and the glabella (the most prominent point on the frontal bone above the root of the nose), in the midline, more than two SD below the mean. Alternatively, an apparently decreased distance between the hairline and the glabella. Evidence: TAS. Frequency: Very frequent (HP:0040281). (ORPHA:1517)
- Prominent supraorbital ridges (HP:0000336): Greater than average forward and/or lateral protrusion of the supraorbital portion of the frontal bones. Evidence: TAS. Frequency: Frequent (HP:0040282). (ORPHA:1517)
- Long philtrum (HP:0000343): Distance between nasal base and midline upper lip vermilion border more than 2 SD above the mean. Alternatively, an apparently increased distance between nasal base and midline upper lip vermilion border. Evidence: TAS. Frequency: Very frequent (HP:0040281). (ORPHA:1517)
- Wide nasal bridge (HP:0000431): Increased breadth of the nasal bridge (and with it, the nasal root). Evidence: TAS. Frequency: Frequent (HP:0040282). (ORPHA:1517)
- Anteverted nares (HP:0000463): Anteriorly-facing nostrils viewed with the head in the Frankfurt horizontal and the eyes of the observer level with the eyes of the subject. This gives the appearance of an upturned nose (upturned nasal tip). Evidence: TAS. Frequency: Frequent (HP:0040282). (ORPHA:1517)
- Short neck (HP:0000470): Diminished length of the neck. Evidence: TAS. Frequency: Frequent (HP:0040282). (ORPHA:1517)
- Long eyelashes (HP:0000527): Mid upper eyelash length >10 mm or increased length of the eyelashes (subjective). Evidence: TAS. Frequency: Very frequent (HP:0040281). (ORPHA:1517)
- Thick eyebrow (HP:0000574): Increased density/number and/or increased diameter of eyebrow hairs. Evidence: TAS. Frequency: Very frequent (HP:0040281). (ORPHA:1517)
- Narrow chest (HP:0000774): Reduced width of the chest from side to side, associated with a reduced distance from the sternal notch to the tip of the shoulder. Evidence: TAS. Frequency: Frequent (HP:0040282). (ORPHA:1517)
- Broad ribs (HP:0000885): Increased width of ribs. Evidence: TAS. Frequency: Frequent (HP:0040282). (ORPHA:1517)
- Platyspondyly (HP:0000926): A flattened vertebral body shape with reduced distance between the vertebral endplates. Evidence: TAS. Frequency: Frequent (HP:0040282). (ORPHA:1517)
- Osteoporosis (HP:0000939): Osteoporosis is a systemic skeletal disease characterized by low bone density and microarchitectural deterioration of bone tissue with a consequent increase in bone fragility. According to the WHO criteria, osteoporosis is defined as a BMD that lies 2.5 standard deviations or more below the average value for young healthy adults (a T-score below -2.5 SD). Evidence: TAS. Frequency: Frequent (HP:0040282). (ORPHA:1517)
- Abnormal metaphysis morphology (HP:0000944): An abnormality of one or more metaphysis, i.e., of the somewhat wider portion of a long bone that is adjacent to the epiphyseal growth plate and grows during childhood. Evidence: TAS. Frequency: Very frequent (HP:0040281). (ORPHA:1517)
- Mild intellectual disability (HP:0001256): Mild intellectual disability (ID) is defined as a type of ID characterized by mildly sub-average adaptive functioning and intellectual functioning, with an intelligence quotient (IQ) the range of 50-69. Evidence: TAS. Frequency: Frequent (HP:0040282). (ORPHA:1517)
- Umbilical hernia (HP:0001537): Protrusion of abdominal contents through a defect in the abdominal wall musculature around the umbilicus. Skin and subcutaneous tissue overlie the defect. Evidence: TAS. Frequency: Frequent (HP:0040282). (ORPHA:1517)
- Hypertrophic cardiomyopathy (HP:0001639): Hypertrophic cardiomyopathy (HCM) is defined by the presence of increased ventricular wall thickness or mass in the absence of loading conditions (hypertension, valve disease) sufficient to cause the observed abnormality. Evidence: TAS. Frequency: Occasional (HP:0040283). (ORPHA:1517)
- Cardiomegaly (HP:0001640): Increased size of the heart, clinically defined as an increased transverse diameter of the cardiac silhouette that is greater than or equal to 50% of the transverse diameter of the chest (increased cardiothoracic ratio) on a posterior-anterior projection of a chest radiograph or a computed tomography. Evidence: TAS. Frequency: Very frequent (HP:0040281). (ORPHA:1517)
- Patent ductus arteriosus (HP:0001643): In utero, the ductus arteriosus (DA) serves to divert ventricular output away from the lungs and toward the placenta by connecting the main pulmonary artery to the descending aorta. A patent ductus arteriosus (PDA) in the first 3 days of life is a physiologic shunt in healthy term and preterm newborn infants, and normally is substantially closed within about 24 hours after bith and completely closed after about three weeks. Failure of physiologcal closure is referred to a persistent or patent ductus arteriosus (PDA). Depending on the degree of left-to-right shunting, PDA can have clinical consequences. Evidence: TAS. Frequency: Frequent (HP:0040282). (ORPHA:1517)
- Abnormal heart valve morphology (HP:0001654): Any structural abnormality of a cardiac valve. Evidence: TAS. Frequency: Occasional (HP:0040283). (ORPHA:1517)
- Deep plantar creases (HP:0001869): The presence of unusually deep creases (ridges/wrinkles) on the skin of sole of foot. Evidence: TAS. Frequency: Frequent (HP:0040282). (ORPHA:1517)
- Low posterior hairline (HP:0002162): Hair on the neck extends more inferiorly than usual. Evidence: TAS. Frequency: Very frequent (HP:0040281). (ORPHA:1517)
- Generalized hirsutism (HP:0002230): Abnormally increased hair growth over much of the entire body. Evidence: TAS. Frequency: Very frequent (HP:0040281). (ORPHA:1517)
- Skeletal dysplasia (HP:0002652): A general term describing features characterized by abnormal development of bones and connective tissues. Evidence: TAS. Frequency: Frequent (HP:0040282). (ORPHA:1517)
- Coxa valga (HP:0002673): Coxa valga is a deformity of the hip in which the angle between the femoral shaft and the femoral neck is increased compared to age-adjusted values (about 150 degrees in newborns gradually reducing to 120-130 degrees in adults). Evidence: TAS. Frequency: Very frequent (HP:0040281). (ORPHA:1517)
- Delayed skeletal maturation (HP:0002750): A decreased rate of skeletal maturation. Delayed skeletal maturation can be diagnosed on the basis of an estimation of the bone age from radiographs of specific bones in the human body. Evidence: TAS. Frequency: Frequent (HP:0040282). (ORPHA:1517)
- Ovoid vertebral bodies (HP:0003300): When viewed in lateral radiographs, vertebral bodies have a roughly rectangular configuration. This term applies if the vertebral body appears rounded or oval. Evidence: TAS. Frequency: Frequent (HP:0040282). (ORPHA:1517)
- Cuboid-shaped vertebral bodies (HP:0004634). Evidence: TAS. Frequency: Frequent (HP:0040282). (ORPHA:1517)
- Accelerated skeletal maturation (HP:0005616): An abnormally increased rate of skeletal maturation. Accelerated skeletal maturation can be diagnosed on the basis of an estimation of the bone age from radiographs of specific bones in the human body. Evidence: TAS. Frequency: Occasional (HP:0040283). (ORPHA:1517)
- Finger syndactyly (HP:0006101): Webbing or fusion of the fingers, involving soft parts only or including bone structure. Bony fusions are referred to as "bony" Syndactyly if the fusion occurs in a radio-ulnar axis. Fusions of bones of the fingers in a proximo-distal axis are referred to as "Symphalangism". Evidence: TAS. Frequency: Occasional (HP:0040283). (ORPHA:1517)
- Curly eyelashes (HP:0007665): Abnormally curly or curved eyelashes. Evidence: TAS. Frequency: Very frequent (HP:0040281). (ORPHA:1517)
- Short distal phalanx of finger (HP:0009882): Short distance from the end of the finger to the most distal interphalangeal crease or the distal interphalangeal joint flexion point. That is, hypoplasia of one or more of the distal phalanx of finger. Evidence: TAS. Frequency: Frequent (HP:0040282). (ORPHA:1517)
- Broad hallux phalanx (HP:0010059): An increase in width in one or more phalanges of the big toe. Evidence: TAS. Frequency: Frequent (HP:0040282). (ORPHA:1517)
- Short hallux (HP:0010109): Underdevelopment (hypoplasia) of the big toe. Evidence: TAS. Frequency: Frequent (HP:0040282). (ORPHA:1517)
- Thick vermilion border (HP:0012471): Increased width of the skin of vermilion border region of upper lip. Evidence: TAS. Frequency: Very frequent (HP:0040281). (ORPHA:1517)
These phenotypes are associated with the disease Cantú syndrome (ORPHA:1517).